Phenotypes associated with the disease Adrenomyodystrophy (ORPHA:977):
- Megacystis (HP:0000021): Dilatation of the bladder postnatally. Evidence: TAS. Frequency: Very frequent (HP:0040281). (ORPHA:977)
- Abnormality of the urinary system (HP:0000079): An abnormality of the urinary system. Evidence: TAS. Frequency: Very frequent (HP:0040281). (ORPHA:977)
- Megalocornea (HP:0000485): An enlargement of the cornea with normal clarity and function. Megalocornea is diagnosed with a horizontal corneal diameter of 12 mm or more at birth or 13 mm or more after two years of age. Evidence: TAS. Frequency: Very frequent (HP:0040281). (ORPHA:977)
- Seizure (HP:0001250): A seizure is an intermittent abnormality of nervous system physiology characterized by a transient occurrence of signs and/or symptoms due to abnormal excessive or synchronous neuronal activity in the brain. Evidence: TAS. Frequency: Frequent (HP:0040282). (ORPHA:977)
- Hypotonia (HP:0001252): Hypotonia is an abnormally low muscle tone (the amount of tension or resistance to movement in a muscle). Even when relaxed, muscles have a continuous and passive partial contraction which provides some resistance to passive stretching. Hypotonia thus manifests as diminished resistance to passive stretching. Hypotonia is not the same as muscle weakness, although the two conditions can co-exist. Evidence: TAS. Frequency: Very frequent (HP:0040281). (ORPHA:977)
- Hepatic steatosis (HP:0001397): Steatosis is a term used to denote lipid accumulation within hepatocytes. Evidence: TAS. Frequency: Frequent (HP:0040282). (ORPHA:977)
- Failure to thrive (HP:0001508): Failure to thrive (FTT) refers to a child whose physical growth is substantially below the norm. Evidence: TAS. Frequency: Very frequent (HP:0040281). (ORPHA:977)
- Abnormal intestine morphology (HP:0002242): An abnormality of the intestine. The closely related term enteropathy is used to refer to any disease of the intestine. Evidence: TAS. Frequency: Very frequent (HP:0040281). (ORPHA:977)
- Delayed skeletal maturation (HP:0002750): A decreased rate of skeletal maturation. Delayed skeletal maturation can be diagnosed on the basis of an estimation of the bone age from radiographs of specific bones in the human body. Evidence: TAS. Frequency: Frequent (HP:0040282). (ORPHA:977)
- Myopathy (HP:0003198): A disorder of muscle unrelated to impairment of innervation or neuromuscular junction. Evidence: TAS. Frequency: Very frequent (HP:0040281). (ORPHA:977)
- EMG abnormality (HP:0003457): Abnormal results of investigations using electromyography (EMG). Evidence: TAS. Frequency: Very frequent (HP:0040281). (ORPHA:977)
- Short stature (HP:0004322): A height below that which is expected according to age and gender norms. Although there is no universally accepted definition of short stature, many refer to "short stature" as height more than 2 standard deviations below the mean for age and gender (or below the 3rd percentile for age and gender dependent norms). Evidence: TAS. Frequency: Frequent (HP:0040282). (ORPHA:977)
- Reduced bone mineral density (HP:0004349): A reduction of bone mineral density, that is, of the amount of matter per cubic centimeter of bones. Evidence: TAS. Frequency: Frequent (HP:0040282). (ORPHA:977)
- Generalized hyperpigmentation (HP:0007440). Evidence: TAS. Frequency: Frequent (HP:0040282). (ORPHA:977)
- Primary adrenal insufficiency (HP:0008207): Insufficient production of steroid hormones (primarily cortisol) by the adrenal glands as a result of a primary defect in the glands themselves. Evidence: TAS. Frequency: Very frequent (HP:0040281). (ORPHA:977)
- Severe global developmental delay (HP:0011344): A severe delay in the achievement of motor or mental milestones in the domains of development of a child. Evidence: TAS. Frequency: Very frequent (HP:0040281). (ORPHA:977)